Phenotypes associated with the disease polydactyly, postaxial, type A6 (OMIM:615226):
- Congenital onset (HP:0003577): A phenotypic abnormality that is present at birth. Evidence: PCS. Frequency: 4/4. (PMID:23160277)
- Abnormal nail morphology (HP:0001597): Abnormal structure or appearance of the nail. Evidence: PCS. Frequency: 0/4. (PMID:23160277)
- Postaxial hand polydactyly (HP:0001162): Supernumerary digits located at the ulnar side of the hand (that is, on the side with the fifth finger). Evidence: PCS. Frequency: 4/4. (PMID:23160277)
- Broad phalanges of the 5th finger (HP:0009374): Increased width of the phalanges of the 5th finger. Evidence: PCS. Frequency: 4/4. (PMID:23160277)
- Abnormal dental morphology (HP:0006482): An abnormality of the morphology of the tooth. Evidence: PCS. Frequency: 0/4. (PMID:23160277)
- Autosomal recessive inheritance (HP:0000007): A mode of inheritance that is observed for traits related to a gene encoded on one of the autosomes (i.e., the human chromosomes 1-22) in which a trait manifests in individuals with two pathogenic alleles, either homozygotes (two copies of the same mutant allele) or compound heterozygotes (whereby each copy of a gene has a distinct mutant allele). Evidence: PCS. (PMID:23160277)
- Postaxial foot polydactyly (HP:0001830): Polydactyly of the foot most commonly refers to the presence of six toes on one foot. Postaxial polydactyly affects the lateral ray and the duplication may range from a well-formed articulated digit to a rudimentary digit. Evidence: PCS. Frequency: 4/4. (PMID:23160277)
- Abnormal sweat gland morphology (HP:0000971): Any structural abnormality of the sweat gland. Evidence: PCS. Frequency: 0/4. (PMID:23160277)